- Corneal dystrophy (HP:0001131): The term corneal dystrophy embraces a heterogenous group of bilateral genetically determined non-inflammatory corneal diseases that are restricted to the cornea. Evidence: PCS. (PMID:18024964)
- Visual impairment (HP:0000505): Visual impairment (or vision impairment) is vision loss (of a person) to such a degree as to qualify as an additional support need through a significant limitation of visual capability resulting from either disease, trauma, or congenital or degenerative conditions that cannot be corrected by conventional means, such as refractive correction, medication, or surgery. Evidence: PCS. Onset: Late onset (HP:0003584). (PMID:25007886)
- Corneal guttata (HP:0012038): Corneal guttata are droplet-like accumulations of non-banded collagen on the posterior surface of Descemet's membrane. The presence of focal thickenings of Descemet's membrane histologically named guttae. Cornea guttata can be easily diagnosed in vivo and ex vivo by means of specular microscopy as it gives dark areas where no endothelial cells are visible. Evidence: PCS. Frequency: 4/4. (PMID:25007886)
- Autosomal dominant inheritance (HP:0000006): A mode of inheritance that is observed for traits related to a gene encoded on one of the autosomes (i.e., the human chromosomes 1-22) in which a trait manifests in heterozygotes. In the context of medical genetics, an autosomal dominant disorder is caused when a single copy of the mutant allele is present. Males and females are affected equally, and can both transmit the disorder with a risk of 50% for each child of inheriting the mutant allele. Evidence: PCS. (PMID:18024964)
These phenotypes are associated with the disease corneal dystrophy, Fuchs endothelial, 4 (OMIM:613268).